Phenotypes associated with the disease Brugada syndrome (ORPHA:130):
- Syncope (HP:0001279): A transient loss of consciousness (i.e., characterized by a rapid onset, a short duration, and a spontaneous and complete recovery) due to cerebral hypoperfusion. Evidence: TAS. Frequency: Frequent (HP:0040282). (ORPHA:130)
- Cardiac arrest (HP:0001695): An abrupt loss of heart function. Evidence: TAS. Frequency: Frequent (HP:0040282). (ORPHA:130)
- Complete right bundle branch block (HP:0011712): A conduction block of the right branch of the bundle of His. This manifests as a prolongation of the QRS complex (greater than 0.12 s) with delayed activation of the right ventricle and terminal delay on the EKG. Evidence: TAS. Frequency: Frequent (HP:0040282). (ORPHA:130)
- ST segment elevation (HP:0012251): An electrocardiographic anomaly in which the ST segment is observed to be located superior to the isoelectric line. Evidence: TAS. Frequency: Frequent (HP:0040282). (ORPHA:130)
- Tachycardia (HP:0001649): A rapid heartrate that exceeds the range of the normal resting heartrate for age. Evidence: TAS. Frequency: Occasional (HP:0040283). (ORPHA:130)
- Ventricular fibrillation (HP:0001663): Uncontrolled contractions of muscles fibers in the left ventricle not producing contraction of the left ventricle. Ventricular fibrillation usually begins with a ventricular premature contraction and a short run of rapid ventricular tachycardia degenerating into uncoordinating ventricular fibrillations. Evidence: TAS. Frequency: Occasional (HP:0040283). (ORPHA:130)
- Paroxysmal ventricular tachycardia (HP:0004751): Episodes of ventricular tachycardia that have a sudden onset and ending. Evidence: TAS. Frequency: Occasional (HP:0040283). (ORPHA:130)
- Supraventricular tachycardia (HP:0004755): Supraventricular tachycardia (SVT) is an abnormally increased heart rate (over 100 beats per minute at rest) with origin above the level of the ventricles. Evidence: TAS. Frequency: Occasional (HP:0040283). (ORPHA:130)
- Sick sinus syndrome (HP:0011704): An abnormality involving the generation of the action potential by the sinus node and is characterized by an atrial rate inappropriate for physiological requirements. Manifestations include severe sinus bradycardia, sinus pauses or arrest, sinus node exit block, chronic atrial tachyarrhythmias, alternating periods of atrial bradyarrhythmias and tachyarrhythmias, and inappropriate responses of heart rate during exercise or stress. Evidence: TAS. Frequency: Occasional (HP:0040283). (ORPHA:130)
- First degree atrioventricular block (HP:0011705): Delay of conduction through the atrioventricular node, which is manifested as prolongation of the PR interval in the electrocardiogram (EKG). All atrial impulses reach the ventricles. Evidence: TAS. Frequency: Occasional (HP:0040283). (ORPHA:130)
- Ventricular arrhythmia (HP:0004308). Evidence: TAS. Frequency: Very rare (HP:0040284). (ORPHA:130)
- Trifascicular block (HP:0011715): Abnormal conduction in all three divisions of the intraventricular conducting tissue. Evidence: TAS. Frequency: Very rare (HP:0040284). (ORPHA:130)